- Autoimmunity (HP:0002960): The occurrence of an immune reaction against the organism's own cells or tissues. Evidence: IEA. (OMIM:270150)
- Elevated erythrocyte sedimentation rate (HP:0003565): An increased erythrocyte sedimentation rate (ESR). The ESR is a test that measures the distance that erythrocytes have fallen after one hour in a vertical column of anticoagulated blood under the influence of gravity. The ESR is a nonspecific finding. An elevation may indicate inflammation or may be caused by any condition that elevates fibrinogen. Evidence: PCS. Frequency: 25/60. (PMID:36717930)
- Tubulointerstitial nephritis (HP:0001970): A form of inflammation of the kidney affecting the interstitium of the kidneys surrounding the tubules. Evidence: TAS. (OMIM:270150)
- Rheumatoid arthritis (HP:0001370): Inflammatory changes in the synovial membranes and articular structures with widespread fibrinoid degeneration of the collagen fibers in mesenchymal tissues, as well as atrophy and rarefaction of bony structures. Evidence: IEA. (OMIM:270150)
- Keratoconjunctivitis sicca (HP:0001097): Dryness of the eye related to deficiency of the tear film components (aqueous, mucin, or lipid), lid surface abnormalities, or epithelial abnormalities. Keratoconjunctivitis sicca often results in a scratchy or sandy sensation (foreign body sensation) in the eyes, and may also be associated with itching, inability to produce tears, photosensitivity, redness, pain, and difficulty in moving the eyelids. Evidence: PCS. Frequency: 46/60. (PMID:36717930)
- Raynaud phenomenon (HP:0030880). Evidence: PCS. Frequency: 22/60. (PMID:36717930)
- Elevated circulating globulin concentration (HP:0032311): The concentration of globulins in the blood circulation is above the upper limit of normal. Evidence: PCS. Frequency: 26/60. (PMID:36717930)
- Enlargement of parotid gland (HP:0011801): Increased size of the parotid gland. Evidence: PCS. (PMID:36063040)
- Anti-La/SS-B antibody positivity (HP:0032235): The presence of autoantibodies in the blood circulation that react against La/SSB autoantigens. Evidence: PCS. Frequency: 32/60. (PMID:36717930)
- Anti-Ro/SS-A antibody positivity (HP:0033555): The presence of autoantibodies in the blood circulation that react against Ro/SSA autoantigens. Evidence: PCS. Frequency: 53/60. (PMID:36717930)
- Decreased circulating complement C4 concentration (HP:0045042): Concentration of the complement component C4 in the blood circulation below the lower limit of normal. Evidence: PCS. Frequency: 19/60. (PMID:36717930)
- Elevated circulating C-reactive protein concentration (HP:0011227): The concentration of C-reactive protein in the blood circulation is above the upper limit of normal. Evidence: PCS. Frequency: 24/60. (PMID:36717930)
- Arthralgia (HP:0002829): Joint pain. Evidence: PCS. Frequency: 24/60. (PMID:36717930)
- Cryoglobulinemia (HP:0100778): Increased level of cryoglobulins in the blood. Cryoglobulins are abnormal immunoglobulins, especially IGG or IGM, that precipitate spontaneously when serum is cooled below 37 degrees Celsius. Evidence: PCS. Frequency: 20/60. (PMID:36717930)
- Xerostomia (HP:0000217): Dryness of the mouth due to salivary gland dysfunction. Evidence: PCS. Frequency: 50/60. (PMID:36717930)
- Autosomal recessive inheritance (HP:0000007): A mode of inheritance that is observed for traits related to a gene encoded on one of the autosomes (i.e., the human chromosomes 1-22) in which a trait manifests in individuals with two pathogenic alleles, either homozygotes (two copies of the same mutant allele) or compound heterozygotes (whereby each copy of a gene has a distinct mutant allele). Evidence: IEA. (OMIM:270150)
- Rheumatoid factor positive (HP:0002923): The presence in the serum of an autoantibody directed against the Fc portion of IgG. Evidence: PCS. Frequency: 28/60. (PMID:36717930)
- Skin rash (HP:0000988): A red eruption of the skin. Evidence: PCS. Frequency: 20/60. (PMID:36717930)
These phenotypes are associated with the disease Sjogren syndrome (OMIM:270150).